Phenotypes associated with the disease PULMONARY ARTERIOVENOUS FISTULAS (OMIM:265140):
- Pulmonary arteriovenous fistulas (HP:0004952): A rare vascular anomaly with a direct communication between pulmonary artery and pulmonary vein without an intervening capillary bed. Evidence: IEA. (OMIM:265140)
- Clubbing of fingers (HP:0100759): Terminal broadening of the fingers (distal phalanges of the fingers). Evidence: TAS. (OMIM:265140)
- Cyanosis (HP:0000961): Bluish discoloration of the skin and mucosa due to poor circulation or inadequate oxygenation of arterial or capillary blood. Evidence: IEA. (OMIM:265140)
- Clubbing of toes (HP:0100760): Terminal broadening of the toes (distal phalanges of the toes). Evidence: TAS. (OMIM:265140)